Phenotypes associated with the disease citrulline transport defect (OMIM:215720):
- Abnormality of metabolism/homeostasis (HP:0001939). Evidence: IEA. (OMIM:215720)
- Autosomal recessive inheritance (HP:0000007): A mode of inheritance that is observed for traits related to a gene encoded on one of the autosomes (i.e., the human chromosomes 1-22) in which a trait manifests in individuals with two pathogenic alleles, either homozygotes (two copies of the same mutant allele) or compound heterozygotes (whereby each copy of a gene has a distinct mutant allele). Evidence: IEA. (OMIM:215720)
- Growth delay (HP:0001510): A deficiency or slowing down of growth pre- and postnatally. Evidence: IEA. (OMIM:215720)